- Typified by somatic mosaicism (HP:0001442): Description of conditions in which affected individuals typically display somatic mosaicism, i.e., genetically distinct populations of somatic cells in a given organism caused by DNA mutations, epigenetic alterations of DNA, chromosomal abnormalities or the spontaneous reversion of inherited mutations. In many conditions typified by somatic mosaicism, constitutive mutation is lethal and cases are exclusively or predominantly mosaic. Evidence: TAS. (OMIM:612237)
- Chondrosarcoma (HP:0006765): A slowly growing malignant neoplasm derived from cartilage cells. Evidence: TAS. (OMIM:612237)
These phenotypes are associated with the disease extraskeletal myxoid chondrosarcoma (OMIM:612237).